Phenotypes associated with the disease aortic aneurysm, familial thoracic 7 (OMIM:613780):
- Aortic rupture (HP:0031649): Tearing of the aortic wall generally associated with profuse internal bleeding. Evidence: PCS. Frequency: 2/5. (PMID:27586135)
- Descending aortic dissection (HP:0012499): A separation of the layers within the wall of the descending aorta. Tears in the intimal layer result in the propagation of dissection (proximally or distally) secondary to blood entering the intima-media space. Evidence: PCS. Frequency: 2/17. Onset: Adult onset (HP:0003581). (PMID:21055718)
- Ascending aortic dissection (HP:0004933): A separation of the layers within the wall of the ascending aorta. Tears in the intimal layer result in the propagation of dissection (proximally or distally) secondary to blood entering the intima-media space. Evidence: PCS. Frequency: 7/17. Onset: Adult onset (HP:0003581). (PMID:21055718)
- Ascending aortic dissection (HP:0004933): A separation of the layers within the wall of the ascending aorta. Tears in the intimal layer result in the propagation of dissection (proximally or distally) secondary to blood entering the intima-media space. Evidence: PCS. Frequency: 3/5. (PMID:27586135)
- Autosomal dominant inheritance (HP:0000006): A mode of inheritance that is observed for traits related to a gene encoded on one of the autosomes (i.e., the human chromosomes 1-22) in which a trait manifests in heterozygotes. In the context of medical genetics, an autosomal dominant disorder is caused when a single copy of the mutant allele is present. Males and females are affected equally, and can both transmit the disorder with a risk of 50% for each child of inheriting the mutant allele. Evidence: PCS. (PMID:21055718)
- Aortic aneurysm (HP:0004942): Aortic dilatation refers to a dimension that is greater than the 95th percentile for the normal person age, sex and body size. In contrast, an aneurysm is defined as a localized dilation of the aorta that is more than 150 percent of predicted (ratio of observed to expected diameter 1.5 or more). Aneurysm should be distinguished from ectasia, which represents a diffuse dilation of the aorta less than 50 percent of normal aorta diameter. Evidence: PCS. (PMID:21055718)
- Sudden death (HP:0001699): Rapid and unexpected death. Evidence: PCS. Frequency: 1/17. (PMID:21055718)